- HSV encephalitis (HP:0012302): Infection of the brain parenchyma with herpes simplex virus, resulting in inflammation of the brain parenchyma with neurologic dysfunction. Evidence: PCS. Frequency: 5/5. (PMID:31806906)
- Autosomal dominant inheritance (HP:0000006): A mode of inheritance that is observed for traits related to a gene encoded on one of the autosomes (i.e., the human chromosomes 1-22) in which a trait manifests in heterozygotes. In the context of medical genetics, an autosomal dominant disorder is caused when a single copy of the mutant allele is present. Males and females are affected equally, and can both transmit the disorder with a risk of 50% for each child of inheriting the mutant allele. Evidence: PCS. (PMID:31806906)
These phenotypes are associated with the disease encephalopathy, acute, infection-induced (herpes-specific), susceptibility to, 10 (OMIM:619396).